- Tibial bowing (HP:0002982): A bending or abnormal curvature of the tibia. Evidence: TAS. Frequency: Very frequent (HP:0040281). (ORPHA:2768)
- Abnormality of the knee (HP:0002815): An abnormality of the knee joint or surrounding structures. Evidence: TAS. Frequency: Frequent (HP:0040282). (ORPHA:2768)
- Abnormal tibial metaphysis morphology (HP:0006491). Evidence: TAS. Frequency: Frequent (HP:0040282). (ORPHA:2768)
- Abnormality of the proximal tibial epiphysis (HP:0010591): Any abnormality of the proximal epiphysis of the tibia. Evidence: TAS. Frequency: Frequent (HP:0040282). (ORPHA:2768)
- Osteochondrosis (HP:0040188): Abnormal growth ossification centers in children. Initially a degeneration/ necrosis followed by regeneration or recalcification. Evidence: TAS. Frequency: Frequent (HP:0040282). (ORPHA:2768)
These phenotypes are associated with the disease Blount disease (ORPHA:2768).